Phenotypes associated with the disease heart defect - tongue hamartoma - polysyndactyly syndrome (OMIM:217085):
- Subvalvular aortic stenosis (HP:0001682): A fixed form of obstruction to blood flow across the left-ventricular outflow tract related to stenosis (narrowing) below the level of the aortic valve. Evidence: TAS. (OMIM:217085)
- Congenital onset (HP:0003577): A phenotypic abnormality that is present at birth. Evidence: PCS. Frequency: 1/1. (PMID:25427950)
- Complete atrioventricular canal defect (HP:0001674): A congenital heart defect characterized by a specific combination of heart defects with a common atrioventricular valve, primum atrial septal defect and inlet ventricular septal defect. Evidence: IEA. (OMIM:217085)
- 2-3 finger cutaneous syndactyly (HP:0001233): A soft tissue continuity in the anteroposterior axis between the second to the third fingers that extends distally to at least the level of the proximal interphalangeal joints. Evidence: TAS. (OMIM:217085)
- Postaxial polydactyly type A (HP:0005696): Supernumerary digits located at the ulnar side of the hand with a complete extra finger and extra metacarpal. Evidence: PCS. Frequency: 1/1. (PMID:25427950)
- Postaxial hand polydactyly (HP:0001162): Supernumerary digits located at the ulnar side of the hand (that is, on the side with the fifth finger). Evidence: IEA. (OMIM:217085)
- Feeding difficulties (HP:0011968): Impaired ability to eat related to problems gathering food and getting ready to suck, chew, or swallow it. Evidence: PCS. Frequency: 1/1. (PMID:25427950)
- Global developmental delay (HP:0001263): A delay in the achievement of motor or mental milestones in the domains of development of a child, including motor skills, speech and language, cognitive skills, and social and emotional skills. This term should only be used to describe children younger than five years of age. Evidence: PCS. Frequency: 0/1. (PMID:25427950)
- Coarctation of aorta (HP:0001680): Coarctation of the aorta is a narrowing or constriction of a segment of the aorta. Evidence: PCS. Frequency: 1/1. (PMID:25427950)
- 2-3 toe syndactyly (HP:0004691): Syndactyly with fusion of toes two and three. Evidence: PCS. Frequency: 1/1. (PMID:25427950)
- Hamartoma of tongue (HP:0011802): A benign (noncancerous) tumorlike malformation made up of an abnormal mixture of cells and tissues that originates in the tongue. Evidence: PCS. Frequency: 1/1. (PMID:25427950)
- Broad hallux (HP:0010055): Visible increase in width of the hallux without an increase in the dorso-ventral dimension. Evidence: PCS. Frequency: 1/1. (PMID:25427950)
- Hypertelorism (HP:0000316): Interpupillary distance more than 2 SD above the mean (alternatively, the appearance of an increased interpupillary distance or widely spaced eyes). Evidence: PCS. Frequency: 0/1. (PMID:25427950)
- Autosomal recessive inheritance (HP:0000007): A mode of inheritance that is observed for traits related to a gene encoded on one of the autosomes (i.e., the human chromosomes 1-22) in which a trait manifests in individuals with two pathogenic alleles, either homozygotes (two copies of the same mutant allele) or compound heterozygotes (whereby each copy of a gene has a distinct mutant allele). Evidence: PCS. (PMID:25427950)
- Orofacial cleft (HP:0000202): The presence of a cleft (gap, opening, or groove) in the oral cavity, including cleft of the upper lip and/or cleft of the palate. Cleft of the upper lip is visible as a groove or fissure in the lip, most frequently due to a congenital failure of the maxillary and median nasal processes to fuse. Cleft palate is characterized by a grooved depression or fissure in the roof of the mouth, most often resulting from a congenital failure of the palate to fuse properly. Clefts of the lip and palate can occur individually or together. It is preferable to code each defect separately. Evidence: PCS. Frequency: 0/1. (PMID:25427950)